- Pruritus (HP:0000989): Pruritus is an itch or a sensation that makes a person want to scratch. This term refers to an abnormally increased disposition to experience pruritus. Evidence: PCS. (PMID:24068131)
- Autosomal dominant inheritance (HP:0000006): A mode of inheritance that is observed for traits related to a gene encoded on one of the autosomes (i.e., the human chromosomes 1-22) in which a trait manifests in heterozygotes. In the context of medical genetics, an autosomal dominant disorder is caused when a single copy of the mutant allele is present. Males and females are affected equally, and can both transmit the disorder with a risk of 50% for each child of inheriting the mutant allele. Evidence: TAS. (OMIM:601230)
These phenotypes are associated with the disease dermatitis herpetiformis, familial (OMIM:601230).